Phenotypes associated with the disease Drug-induced autoimmune hemolytic anemia (ORPHA:90037):
- Pallor (HP:0000980): Abnormally pale skin. Evidence: TAS. Frequency: Very frequent (HP:0040281). (ORPHA:90037)
- Muscle weakness (HP:0001324): Reduced strength of muscles. Evidence: TAS. Frequency: Very frequent (HP:0040281). (ORPHA:90037)
- Congestive heart failure (HP:0001635): The presence of an abnormality of cardiac function that is responsible for the failure of the heart to pump blood at a rate that is commensurate with the needs of the tissues or a state in which abnormally elevated filling pressures are required for the heart to do so. Heart failure is frequently related to a defect in myocardial contraction. Evidence: TAS. Frequency: Occasional (HP:0040283). (ORPHA:90037)
- Tachycardia (HP:0001649): A rapid heartrate that exceeds the range of the normal resting heartrate for age. Evidence: TAS. Frequency: Occasional (HP:0040283). (ORPHA:90037)
- Splenomegaly (HP:0001744): Abnormal increased size of the spleen. Evidence: TAS. Frequency: Occasional (HP:0040283). (ORPHA:90037)
- Autoimmune hemolytic anemia (HP:0001890): An autoimmune form of hemolytic anemia. Evidence: TAS. Frequency: Very frequent (HP:0040281). (ORPHA:90037)
- Headache (HP:0002315): Cephalgia, or pain sensed in various parts of the head, not confined to the area of distribution of any nerve. Evidence: TAS. Frequency: Very frequent (HP:0040281). (ORPHA:90037)
- Exertional dyspnea (HP:0002875): Perceived difficulty to breathe that occurs with exercise or exertion and improves with rest. Evidence: TAS. Frequency: Very frequent (HP:0040281). (ORPHA:90037)
- Increased total bilirubin (HP:0003573): Increased concentration of total (conjugated and unconjugated) bilirubin in the blood. Evidence: TAS. Frequency: Occasional (HP:0040283). (ORPHA:90037)
- Abnormal urinary color (HP:0012086): An abnormal color of the urine, that is, the color of the urine appears different from the usual straw-yellow color. Evidence: TAS. Frequency: Occasional (HP:0040283). (ORPHA:90037)
- Fatigue (HP:0012378): A subjective feeling of tiredness characterized by a lack of energy and motivation. Evidence: TAS. Frequency: Very frequent (HP:0040281). (ORPHA:90037)